- Barrett esophagus (HP:0100580): An abnormal change (metaplasia) in the cells of the inferior portion of the esophagus. The normal squamous epithelium lining of the esophagus is replaced by metaplastic columnar epithelium. Columnar epithelium refers to a cell type that is typically found in more distal parts of the gastrointestinal system. Evidence: TAS. Frequency: Very frequent (HP:0040281). (ORPHA:231080)
- Dysphagia (HP:0002015): Difficulty in swallowing. Evidence: TAS. Frequency: Frequent (HP:0040282). (ORPHA:231080)
- Gastroesophageal reflux (HP:0002020): A condition in which the stomach contents leak backwards from the stomach into the esophagus through the lower esophageal sphincter. Evidence: TAS. Frequency: Frequent (HP:0040282). (ORPHA:231080)
- Esophageal obstruction (HP:0005240). Evidence: TAS. Frequency: Occasional (HP:0040283). (ORPHA:231080)
These phenotypes are associated with the disease High-grade dysplasia in patients with Barrett esophagus (ORPHA:231080).